- Abnormality of metabolism/homeostasis (HP:0001939). Evidence: IEA. (OMIM:223380)
- Autosomal recessive inheritance (HP:0000007): A mode of inheritance that is observed for traits related to a gene encoded on one of the autosomes (i.e., the human chromosomes 1-22) in which a trait manifests in individuals with two pathogenic alleles, either homozygotes (two copies of the same mutant allele) or compound heterozygotes (whereby each copy of a gene has a distinct mutant allele). Evidence: IEA. (OMIM:223380)
These phenotypes are associated with the disease Dopamine beta-hydroxylase, plasma, thermolability of (OMIM:223380).